- Lymphadenopathy (HP:0002716): Enlargement (swelling) of a lymph node. Evidence: TAS. Frequency: Occasional (HP:0040283). (ORPHA:99826)
- Arthralgia (HP:0002829): Joint pain. Evidence: TAS. Frequency: Occasional (HP:0040283). (ORPHA:99826)
- Hypokalemia (HP:0002900): The concentration of potassium(1+) in the blood circulation is below the lower limit of normal. Evidence: TAS. Frequency: Occasional (HP:0040283). (ORPHA:99826)
- Elevated circulating hepatic transaminase concentration (HP:0002910): Elevations of the levels of SGOT and SGPT in the serum. SGOT (serum glutamic oxaloacetic transaminase) and SGPT (serum glutamic pyruvic transaminase) are transaminases primarily found in the liver and heart and are released into the bloodstream as the result of liver or heart damage. SGOT and SGPT are used clinically mainly as markers of liver damage. Evidence: TAS. Frequency: Occasional (HP:0040283). (ORPHA:99826)
- Hypoalbuminemia (HP:0003073): The concentration of albumin in the blood circulation is below the lower limit of normal. Evidence: TAS. Frequency: Occasional (HP:0040283). (ORPHA:99826)
- Lactic acidosis (HP:0003128): An abnormal buildup of lactic acid in the body, leading to acidification of the blood and other bodily fluids. Evidence: TAS. Frequency: Occasional (HP:0040283). (ORPHA:99826)
- Elevated circulating creatine kinase activity (HP:0003236): The activity of creatine kinase in the blood circulation is above the upper limit of normal. Evidence: TAS. Frequency: Occasional (HP:0040283). (ORPHA:99826)
- Abnormality of the coagulation cascade (HP:0003256): An abnormality of the coagulation cascade, which is comprised of the contact activation pathway (also known as the intrinsic pathway) and the tissue factor pathway (also known as the extrinsic pathway) as well as cofactors and regulators. Evidence: TAS. Frequency: Occasional (HP:0040283). (ORPHA:99826)
- Elevated circulating creatinine concentration (HP:0003259): An increased amount of creatinine in the blood. Evidence: TAS. Frequency: Occasional (HP:0040283). (ORPHA:99826)
- Back pain (HP:0003418): An unpleasant sensation characterized by physical discomfort (such as pricking, throbbing, or aching) localized to the back. Evidence: TAS. Frequency: Occasional (HP:0040283). (ORPHA:99826)
- Prolonged partial thromboplastin time (HP:0003645): Increased time to coagulation in the partial thromboplastin time (PTT) test, a measure of the intrinsic and common coagulation pathways. Phospholipid, and activator, and calcium are mixed into an anticoagulated plasma sample, and the time is measured until a thrombus forms. Evidence: TAS. Frequency: Occasional (HP:0040283). (ORPHA:99826)
- Prolonged prothrombin time (HP:0008151): Increased time to coagulation in the prothrombin time test, which is a measure of the extrinsic pathway of coagulation. The results of the prothrombin time test are often expressed in terms of the International normalized ratio (INR), which is calculated as a ratio of the patient's prothrombin time (PT) to a control PT standardized for the potency of the thromboplastin reagent developed by the World Health Organization (WHO) using the formula: INR is equal to Patient PT divided by Control PT. Evidence: TAS. Frequency: Occasional (HP:0040283). (ORPHA:99826)
- Internal hemorrhage (HP:0011029): The presence of hemorrhage within the body. Evidence: TAS. Frequency: Occasional (HP:0040283). (ORPHA:99826)
- Atypical absence status epilepticus (HP:0011151): Atypical absence status epilepticus is a type of generalized non-convulsive status epilepticus without coma that is semiologically a prolonged atypical absence seizure. Evidence: TAS. Frequency: Occasional (HP:0040283). (ORPHA:99826)
- Subconjunctival hemorrhage (HP:0011896): Bleeding beneath the mucous membrane that lines the inner surface of the eyelid. Evidence: TAS. Frequency: Occasional (HP:0040283). (ORPHA:99826)
- Dysesthesia (HP:0012534): Painful sensations elicited by a nonpainful cutaneous stimulus such as a light touch or gentle stroking over affected areas of the body. Sometimes referred to as hyperpathia or hyperalgesia. Often perceived as an intense burning, dyesthesias may outlast the stimulus by several seconds. Evidence: TAS. Frequency: Occasional (HP:0040283). (ORPHA:99826)
- Bloody diarrhea (HP:0025085): Passage of many stools containing blood. Evidence: TAS. Frequency: Occasional (HP:0040283). (ORPHA:99826)
- Excessive bleeding after a venipuncture (HP:0030139): An abnormal high amount of bleeding following the procedure of taking a blood sample. Evidence: TAS. Frequency: Occasional (HP:0040283). (ORPHA:99826)
- Nonproductive cough (HP:0031246): A cough that does not produce phlegm or mucus. Evidence: TAS. Frequency: Occasional (HP:0040283). (ORPHA:99826)
- Shock (HP:0031273): The state in which profound and widespread reduction of effective tissue perfusion leads first to reversible, and then if prolonged, to irreversible cellular injury. Evidence: TAS. Frequency: Occasional (HP:0040283). (ORPHA:99826)
- Maculopapular exanthema (HP:0040186): A skin rash that is characterized by diffuse cutaneous erythema with areas of skin elevation. It may evolve to vesicles or papules as part of a more severe clinical entity. Different degrees of angioedema with involvement of subcutaneous tissue may also appear. Evidence: TAS. Frequency: Occasional (HP:0040283). (ORPHA:99826)
- Hyperamylasemia (HP:0410288): The concentration of amylase in the blood circulation is above the upper limit of normal. Evidence: TAS. Frequency: Occasional (HP:0040283). (ORPHA:99826)
- Uveitis (HP:0000554): Inflammation of one or all portions of the uveal tract. Evidence: TAS. Frequency: Very rare (HP:0040284). (ORPHA:99826)
- Psychosis (HP:0000709): A condition characterized by changes in personality and thought patterns, often accompanied by hallucinations and delusional beliefs, is known as psychosis. Evidence: TAS. Frequency: Very rare (HP:0040284). (ORPHA:99826)
- Decreased total leukocyte count (HP:0001882): An abnormal decreased number of leukocytes in the blood. Evidence: TAS. Frequency: Very frequent (HP:0040281). (ORPHA:99826)
- Decreased total lymphocyte count (HP:0001888): A reduced number of lymphocytes in the blood. Evidence: TAS. Frequency: Very frequent (HP:0040281). (ORPHA:99826)
- Increased circulating immunoglobulin concentration (HP:0010702): An increased level of gamma globulin (immunoglobulin) in the blood. Evidence: TAS. Frequency: Very frequent (HP:0040281). (ORPHA:99826)
- Viremia (HP:0020071): The presence of virus in the blood. Evidence: TAS. Frequency: Very frequent (HP:0040281). (ORPHA:99826)
- Capillary leak (HP:0030005): An acute phenomenon characterized by hypotension and anasarca due to the loss of plasma volume into peripheral tissues, with evidence of decreased plasma volume (hemoconcentration) and protein loss from the intravascular space (hypoalbuminemia) during acute episodes. Evidence: TAS. Frequency: Very frequent (HP:0040281). (ORPHA:99826)
- Abnormal bleeding (HP:0001892): An abnormal susceptibility to bleeding, often referred to as a bleeding diathesis. A bleeding diathesis may be related to vascular, platelet and coagulation defects. Evidence: TAS. Frequency: Frequent (HP:0040282). (ORPHA:99826)
- Reticulocytosis (HP:0001923): An elevation in the number of reticulocytes (immature erythrocytes) in the peripheral blood circulation. Evidence: TAS. Frequency: Frequent (HP:0040282). (ORPHA:99826)
- Fever (HP:0001945): Body temperature elevated above the normal range. Evidence: TAS. Frequency: Frequent (HP:0040282). (ORPHA:99826)
- Vomiting (HP:0002013): Forceful ejection of the contents of the stomach through the mouth by means of a series of involuntary spasmic contractions. Evidence: TAS. Frequency: Frequent (HP:0040282). (ORPHA:99826)
- Diarrhea (HP:0002014): Abnormally increased frequency (usually defined as three or more) loose or watery bowel movements a day. Evidence: TAS. Frequency: Frequent (HP:0040282). (ORPHA:99826)
- Abdominal pain (HP:0002027): An unpleasant sensation characterized by physical discomfort (such as pricking, throbbing, or aching) and perceived to originate in the abdomen. Evidence: TAS. Frequency: Frequent (HP:0040282). (ORPHA:99826)
- Anorexia (HP:0002039): Lack of desire to eat (loss of appetite). Evidence: TAS. Frequency: Frequent (HP:0040282). (ORPHA:99826)
- Headache (HP:0002315): Cephalgia, or pain sensed in various parts of the head, not confined to the area of distribution of any nerve. Evidence: TAS. Frequency: Frequent (HP:0040282). (ORPHA:99826)
- Myalgia (HP:0003326): Pain in muscle. Evidence: TAS. Frequency: Frequent (HP:0040282). (ORPHA:99826)
- Abnormal lymphocyte morphology (HP:0004332): An abnormality of lymphocytes. Evidence: TAS. Frequency: Frequent (HP:0040282). (ORPHA:99826)
- Abnormal number of granulocyte precursors (HP:0012137). Evidence: TAS. Frequency: Frequent (HP:0040282). (ORPHA:99826)
- Chills (HP:0025143): A sudden sensation of feeling cold. Evidence: TAS. Frequency: Frequent (HP:0040282). (ORPHA:99826)
- Conjunctival hyperemia (HP:0030953): Dilatation of the blood vessels of the conjunctiva leading to a red appearance of the sclera. Evidence: TAS. Frequency: Frequent (HP:0040282). (ORPHA:99826)
- Odynophagia (HP:0032043): Pain experienced with swallowing. Evidence: TAS. Frequency: Frequent (HP:0040282). (ORPHA:99826)
- Severe infection (HP:0032169): A type of infection that is regarded as a sign of a pathological susceptibility to infection because of unusual severity or intensity of the infection. Evidence: TAS. Frequency: Frequent (HP:0040282). (ORPHA:99826)
- Neutrophilia in presence of infection (HP:0410257): An increased number of neutrophils circulating in the blood during an infection, such as with a bacteria, virus or fungus. Evidence: TAS. Frequency: Frequent (HP:0040282). (ORPHA:99826)
- Renal insufficiency (HP:0000083): A reduction in the level of performance of the kidneys in areas of function comprising the concentration of urine, removal of wastes, the maintenance of electrolyte balance, homeostasis of blood pressure, and calcium metabolism. Evidence: TAS. Frequency: Occasional (HP:0040283). (ORPHA:99826)
- Aggressive behavior (HP:0000718): Behavior or an act aimed at harming a person, animal, or physical property (e.g., acts of physical violence; shouting, swearing, and using harsh language; slashing someone's tires). Evidence: TAS. Frequency: Occasional (HP:0040283). (ORPHA:99826)
- Petechiae (HP:0000967): Petechiae are pinpoint-sized reddish/purple spots, resembling a rash, that appear just under the skin or a mucous membrane when capillaries have ruptured and some superficial bleeding into the skin has happened. This term refers to an abnormally increased susceptibility to developing petechiae. Evidence: TAS. Frequency: Occasional (HP:0040283). (ORPHA:99826)
- Bruising susceptibility (HP:0000978): An ecchymosis (bruise) refers to the skin discoloration caused by the escape of blood into the tissues from ruptured blood vessels. This term refers to an abnormally increased susceptibility to bruising. The corresponding phenotypic abnormality is generally elicited on medical history as a report of frequent ecchymoses or bruising without adequate trauma. Evidence: TAS. Frequency: Occasional (HP:0040283). (ORPHA:99826)
- Skin rash (HP:0000988): A red eruption of the skin. Evidence: TAS. Frequency: Occasional (HP:0040283). (ORPHA:99826)
- Seizure (HP:0001250): A seizure is an intermittent abnormality of nervous system physiology characterized by a transient occurrence of signs and/or symptoms due to abnormal excessive or synchronous neuronal activity in the brain. Evidence: TAS. Frequency: Occasional (HP:0040283). (ORPHA:99826)
- Lethargy (HP:0001254): A state of fatigue, either physical or mental slowness and sluggishness, with difficulties in initiating or performing simple tasks. Distinguished from apathy which implies indifference and a lack of desire or interest in the task. A person with lethargy may have the desire, but not the energy to engage in personal or socially relevant tasks. Evidence: TAS. Frequency: Occasional (HP:0040283). (ORPHA:99826)
- Coma (HP:0001259): The complete absence of wakefulness and consciousness, which is evident through a lack of response to any form of external stimuli. Evidence: TAS. Frequency: Occasional (HP:0040283). (ORPHA:99826)
- Confusion (HP:0001289): Lack of clarity and coherence of thought, perception, understanding, or action. Evidence: TAS. Frequency: Occasional (HP:0040283). (ORPHA:99826)
- Tachycardia (HP:0001649): A rapid heartrate that exceeds the range of the normal resting heartrate for age. Evidence: TAS. Frequency: Occasional (HP:0040283). (ORPHA:99826)
- Bradycardia (HP:0001662): A slower than normal heart rate (in adults, slower than 60 beats per minute). Evidence: TAS. Frequency: Occasional (HP:0040283). (ORPHA:99826)
- Thrombocytopenia (HP:0001873): A reduction in the number of circulating thrombocytes. Evidence: TAS. Frequency: Occasional (HP:0040283). (ORPHA:99826)
- Hypoglycemia (HP:0001943): A decreased concentration of glucose in the blood. Evidence: TAS. Frequency: Occasional (HP:0040283). (ORPHA:99826)
- Dehydration (HP:0001944). Evidence: TAS. Frequency: Occasional (HP:0040283). (ORPHA:99826)
- Nausea (HP:0002018): A sensation of unease in the stomach together with an urge to vomit. Evidence: TAS. Frequency: Occasional (HP:0040283). (ORPHA:99826)
- Hypothermia (HP:0002045): Reduced body temperature due to failed thermoregulation. Evidence: TAS. Frequency: Occasional (HP:0040283). (ORPHA:99826)
- Drowsiness (HP:0002329): Abnormal feeling of sleepiness or difficulty staying awake. Evidence: TAS. Frequency: Occasional (HP:0040283). (ORPHA:99826)
- Hypotension (HP:0002615): Low Blood Pressure, vascular hypotension. Evidence: TAS. Frequency: Occasional (HP:0040283). (ORPHA:99826)
- Jaundice (HP:0000952): Yellow pigmentation of the skin due to bilirubin, which in turn is the result of increased bilirubin concentration in the bloodstream. Evidence: TAS. Frequency: Very rare (HP:0040284). (ORPHA:99826)
- Arthritis (HP:0001369): Inflammation of a joint. Evidence: TAS. Frequency: Very rare (HP:0040284). (ORPHA:99826)
- Pericarditis (HP:0001701): Inflammation of the sac-like covering around the heart (pericardium). Evidence: TAS. Frequency: Very rare (HP:0040284). (ORPHA:99826)
- Pancreatitis (HP:0001733): The presence of inflammation in the pancreas. Evidence: TAS. Frequency: Very rare (HP:0040284). (ORPHA:99826)
- Hyperammonemia (HP:0001987): An increased concentration of ammonia in the blood. Evidence: TAS. Frequency: Very rare (HP:0040284). (ORPHA:99826)
- Hepatic encephalopathy (HP:0002480): Central nervous system dysfunction in association with liver failure and characterized clinically (depending on degree of severity) by lethargy, confusion, nystagmus, decorticate posturing, spasticity, and bilateral Babinski reflexes. Evidence: TAS. Frequency: Very rare (HP:0040284). (ORPHA:99826)
- Abnormality of acid-base homeostasis (HP:0004360): An abnormality of the balance or maintenance of the balance of acids and bases in bodily fluids, resulting in an abnormal pH. Evidence: TAS. Frequency: Very rare (HP:0040284). (ORPHA:99826)
- Disseminated intravascular coagulation (HP:0005521): Disseminated intravascular coagulation is characterized by the widespread activation of coagulation, which results in the intravascular formation of fibrin and ultimately thrombotic occlusion of small and midsize vessels. Evidence: TAS. Frequency: Very rare (HP:0040284). (ORPHA:99826)
- Abnormality of the gastrointestinal tract (HP:0011024): An abnormality of the gastrointestinal tract. Evidence: TAS. Frequency: Very rare (HP:0040284). (ORPHA:99826)
- Hypovolemia (HP:0011106): An decrease in the amount of intravascular fluid, particularly in the volume of the circulating blood. Evidence: TAS. Frequency: Very rare (HP:0040284). (ORPHA:99826)
- Orchitis (HP:0100796): Testicular inflammation. Evidence: TAS. Frequency: Very rare (HP:0040284). (ORPHA:99826)
These phenotypes are associated with the disease Marburg hemorrhagic fever (ORPHA:99826).